- Ventricular septal defect (HP:0001629): A hole between the two bottom chambers (ventricles) of the heart. The defect is centered around the most superior aspect of the ventricular septum. Evidence: TAS. Frequency: Occasional (HP:0040283). (ORPHA:284169)
- Pulmonic stenosis (HP:0001642): A narrowing of the right ventricular outflow tract that can occur at the pulmonary valve (valvular stenosis), below the pulmonary valve (infundibular stenosis), or above the pulmonary valve (supravalvar stenosis). Evidence: TAS. Frequency: Occasional (HP:0040283). (ORPHA:284169)
- Patent ductus arteriosus (HP:0001643): In utero, the ductus arteriosus (DA) serves to divert ventricular output away from the lungs and toward the placenta by connecting the main pulmonary artery to the descending aorta. A patent ductus arteriosus (PDA) in the first 3 days of life is a physiologic shunt in healthy term and preterm newborn infants, and normally is substantially closed within about 24 hours after bith and completely closed after about three weeks. Failure of physiologcal closure is referred to a persistent or patent ductus arteriosus (PDA). Depending on the degree of left-to-right shunting, PDA can have clinical consequences. Evidence: TAS. Frequency: Occasional (HP:0040283). (ORPHA:284169)
- Bicuspid aortic valve (HP:0001647): The presence of an aortic valve with two instead of the normal three cusps (flaps). Bicuspid aortic valvue is a malformation of a commissure (small space between the attachment of each cusp to the aortic wall) and the adjacent parts of the two corresponding cusps forming a raphe (the fused area of the two underdeveloped cusps turning into a malformed commissure between both cusps; the raphe is a fibrous ridge that extends from the commissure to the free edge of the two underdeveloped, conjoint cusps). Evidence: TAS. Frequency: Occasional (HP:0040283). (ORPHA:284169)
- Coarctation of aorta (HP:0001680): Coarctation of the aorta is a narrowing or constriction of a segment of the aorta. Evidence: TAS. Frequency: Occasional (HP:0040283). (ORPHA:284169)
- Ventricular hypertrophy (HP:0001714): Enlargement of the cardiac ventricular muscle tissue with increase in the width of the wall of the ventricle and loss of elasticity. Ventricular hypertrophy is clinically differentiated into left and right ventricular hypertrophy. Evidence: TAS. Frequency: Occasional (HP:0040283). (ORPHA:284169)
- Hypoplasia of the corpus callosum (HP:0002079): Underdevelopment of the corpus callosum. Evidence: TAS. Frequency: Occasional (HP:0040283). (ORPHA:284169)
- Ventriculomegaly (HP:0002119): An increase in size of the ventricular system of the brain. Evidence: TAS. Frequency: Occasional (HP:0040283). (ORPHA:284169)
- Celiac disease (HP:0002608): Celiac disease (CD) is an autoimmune condition affecting the small intestine, triggered by the ingestion of gluten, the protein fraction of wheat, barley, and rye. Clinical manifestations of CD are highly variable and include both gastrointestinal and non-gastrointestinal features. The hallmark of CD is an immune-mediated enteropathy. This term is included because the occurrence of CD is seen as a feature of a number of other diseases. Evidence: TAS. Frequency: Occasional (HP:0040283). (ORPHA:284169)
- Short nose (HP:0003196): Distance from nasion to subnasale more than two standard deviations below the mean, or alternatively, an apparently decreased length from the nasal root to the nasal tip. Evidence: TAS. Frequency: Occasional (HP:0040283). (ORPHA:284169)
- Depressed nasal bridge (HP:0005280): Posterior positioning of the nasal root in relation to the overall facial profile for age. Evidence: TAS. Frequency: Occasional (HP:0040283). (ORPHA:284169)
- Absent cupid's bow (HP:0010800): Lack of paramedian peaks and median notch of the upper lip vermilion. Evidence: TAS. Frequency: Occasional (HP:0040283). (ORPHA:284169)
- Prominent forehead (HP:0011220): Forward prominence of the entire forehead, due to protrusion of the frontal bone. Evidence: TAS. Frequency: Occasional (HP:0040283). (ORPHA:284169)
- Visual impairment (HP:0000505): Visual impairment (or vision impairment) is vision loss (of a person) to such a degree as to qualify as an additional support need through a significant limitation of visual capability resulting from either disease, trauma, or congenital or degenerative conditions that cannot be corrected by conventional means, such as refractive correction, medication, or surgery. Evidence: TAS. Frequency: Very frequent (HP:0040281). (ORPHA:284169)
- Atypical behavior (HP:0000708): Atypical behavior is an abnormality in a person's actions that can be controlled or modulated by the will of the individual. While abnormal behaviors can be difficult to control, they are distinct from other abnormal actions that cannot be affected by the individual's will. Evidence: TAS. Frequency: Very frequent (HP:0040281). (ORPHA:284169)
- Delayed speech and language development (HP:0000750): A degree of language development that is significantly below the norm for a child of a specified age. Evidence: TAS. Frequency: Very frequent (HP:0040281). (ORPHA:284169)
- Intellectual disability (HP:0001249): The term intellectual disability or intellectual developmental disorder is used to describe significantly sub-average intellectual and adaptive functioning based on clinical assessment and as measured by individually administered, appropriately normed, standardized and validated tests of intellectual functioning and adaptive behavior, with onset during the developmental period from infancy through adolescence. Evidence: TAS. Frequency: Very frequent (HP:0040281). (ORPHA:284169)
- Global developmental delay (HP:0001263): A delay in the achievement of motor or mental milestones in the domains of development of a child, including motor skills, speech and language, cognitive skills, and social and emotional skills. This term should only be used to describe children younger than five years of age. Evidence: TAS. Frequency: Very frequent (HP:0040281). (ORPHA:284169)
- Motor delay (HP:0001270): A type of Developmental delay characterized by a delay in acquiring motor skills. Evidence: TAS. Frequency: Very frequent (HP:0040281). (ORPHA:284169)
- Abnormal heart morphology (HP:0001627): Any structural anomaly of the heart. Evidence: TAS. Frequency: Very frequent (HP:0040281). (ORPHA:284169)
- Attention deficit hyperactivity disorder (HP:0007018): Attention deficit hyperactivity disorder (ADHD) manifests at age 2-3 years or by first grade at the latest. The main symptoms are distractibility, impulsivity, hyperactivity, and often trouble organizing tasks and projects, difficulty going to sleep, and social problems from being aggressive, loud, or impatient. Evidence: TAS. Frequency: Very frequent (HP:0040281). (ORPHA:284169)
- Abnormal brain morphology (HP:0012443): A structural abnormality of the brain, which has as its parts the forebrain, midbrain, and hindbrain. Evidence: TAS. Frequency: Very frequent (HP:0040281). (ORPHA:284169)
- Full cheeks (HP:0000293): Increased prominence or roundness of soft tissues between zygomata and mandible. Evidence: TAS. Frequency: Frequent (HP:0040282). (ORPHA:284169)
- Astigmatism (HP:0000483): A type of refraction error associated with abnormal curvatures on the anterior and/or posterior surface of the cornea. Evidence: TAS. Frequency: Frequent (HP:0040282). (ORPHA:284169)
- Strabismus (HP:0000486): A misalignment of the eyes so that the visual axes deviate from bifoveal fixation. The classification of strabismus may be based on a number of features including the relative position of the eyes, whether the deviation is latent or manifest, intermittent or constant, concomitant or otherwise and according to the age of onset and the relevance of any associated refractive error. Evidence: TAS. Frequency: Frequent (HP:0040282). (ORPHA:284169)
- Aggressive behavior (HP:0000718): Behavior or an act aimed at harming a person, animal, or physical property (e.g., acts of physical violence; shouting, swearing, and using harsh language; slashing someone's tires). Evidence: TAS. Frequency: Frequent (HP:0040282). (ORPHA:284169)
- Anxiety (HP:0000739): Intense feelings of nervousness, tension, or panic often arise in response to interpersonal stresses. There is worry about the negative effects of past unpleasant experiences and future negative possibilities. Individuals may feel fearful, apprehensive, or threatened by uncertainty, and they may also have fears of falling apart or losing control. Evidence: TAS. Frequency: Frequent (HP:0040282). (ORPHA:284169)
- Seizure (HP:0001250): A seizure is an intermittent abnormality of nervous system physiology characterized by a transient occurrence of signs and/or symptoms due to abnormal excessive or synchronous neuronal activity in the brain. Evidence: TAS. Frequency: Frequent (HP:0040282). (ORPHA:284169)
- Neonatal hypotonia (HP:0001319): Muscular hypotonia (abnormally low muscle tone) manifesting in the neonatal period. Evidence: TAS. Frequency: Frequent (HP:0040282). (ORPHA:284169)
- Constipation (HP:0002019): Infrequent or difficult evacuation of feces. Evidence: TAS. Frequency: Frequent (HP:0040282). (ORPHA:284169)
- Sleep disturbance (HP:0002360): An abnormal pattern in the quality, quantity, or characteristics of sleep. Evidence: TAS. Frequency: Frequent (HP:0040282). (ORPHA:284169)
- Feeding difficulties (HP:0011968): Impaired ability to eat related to problems gathering food and getting ready to suck, chew, or swallow it. Evidence: TAS. Frequency: Frequent (HP:0040282). (ORPHA:284169)
- Short palpebral fissure (HP:0012745): Distance between the medial and lateral canthi is more than 2 SD below the mean for age (objective); or, apparently reduced length of the palpebral fissures. Evidence: TAS. Frequency: Frequent (HP:0040282). (ORPHA:284169)
- Posteriorly rotated ears (HP:0000358): A type of abnormal location of the ears in which the position of the ears is characterized by posterior rotation (the superior part of the ears is rotated towards the back of the head, and the inferior part of the ears towards the front). Evidence: TAS. Frequency: Occasional (HP:0040283). (ORPHA:284169)
- Hearing impairment (HP:0000365): A decreased magnitude of the sensory perception of sound. Evidence: TAS. Frequency: Occasional (HP:0040283). (ORPHA:284169)
- Bulbous nose (HP:0000414): Increased volume and globular shape of the anteroinferior aspect of the nose. Evidence: TAS. Frequency: Occasional (HP:0040283). (ORPHA:284169)
- Choanal atresia (HP:0000453): Absence or abnormal closure of the choana (the posterior nasal aperture). Most embryologists believe that posterior choanal atresia results from a failure of rupture between the 35th and 38th day of fetal life of the partition which separates the bucconasal or buccopharyngeal membranes. The resultant choanal atresia may be unilateral or bilateral, bony or membranous, complete or incomplete. In over 90 per cent of cases the obstruction is bony, while in the remainder it is membranous. The bony type of atresia is commonly located 1-2 mm. anterior to the posterior edge of the hard palate, and the osseous septum varies in thickness from 1 to 10 mm. In the membranous form of choanal atresia the obstruction usually occurs further posteriorly. In approximately one third of cases the atresia is bilateral. Evidence: TAS. Frequency: Occasional (HP:0040283). (ORPHA:284169)
- Deeply set eye (HP:0000490): An eye that is more deeply recessed into the plane of the face than is typical. Evidence: TAS. Frequency: Occasional (HP:0040283). (ORPHA:284169)
- Downslanted palpebral fissures (HP:0000494): The palpebral fissure inclination is more than two standard deviations below the mean. Evidence: TAS. Frequency: Occasional (HP:0040283). (ORPHA:284169)
- Hypermetropia (HP:0000540): An abnormality of refraction characterized by the ability to see objects in the distance clearly, while objects nearby appear blurry. Evidence: TAS. Frequency: Occasional (HP:0040283). (ORPHA:284169)
- Myopia (HP:0000545): An abnormality of refraction characterized by the ability to see objects nearby clearly, while objects in the distance appear blurry. Evidence: TAS. Frequency: Occasional (HP:0040283). (ORPHA:284169)
- Chorioretinal coloboma (HP:0000567): Absence of a region of the retina, retinal pigment epithelium, and choroid. Evidence: TAS. Frequency: Occasional (HP:0040283). (ORPHA:284169)
- Amblyopia (HP:0000646): Reduced visual acuity that is uncorrectable by lenses in the absence of detectable anatomic defects in the eye or visual pathways. Evidence: TAS. Frequency: Occasional (HP:0040283). (ORPHA:284169)
- Synophrys (HP:0000664): Meeting of the medial eyebrows in the midline. Evidence: TAS. Frequency: Occasional (HP:0040283). (ORPHA:284169)
- Autistic behavior (HP:0000729): Persistent deficits in social interaction and communication and interaction as well as a markedly restricted repertoire of activity and interest as well as repetitive patterns of behavior. Evidence: TAS. Frequency: Occasional (HP:0040283). (ORPHA:284169)
- Cerebellar hypoplasia (HP:0001321): Cerebellar hypoplasia is a descriptive term implying a cerebellum with a reduced volume, but a normal shape and is stable over time. Evidence: TAS. Frequency: Occasional (HP:0040283). (ORPHA:284169)
These phenotypes are associated with the disease Facial dysmorphism-developmental delay-behavioral abnormalities syndrome due to 10p11.21p12.31 microdeletion (ORPHA:284169).